Phenotypes associated with the disease premature ovarian failure 1 (OMIM:311360):
- Premature ovarian insufficiency (HP:0008209): Amenorrhea due to loss of ovarian function before the age of 40. Primary ovarian insuficiency (POI) is a state of female hypergonadotropic hypogonadism. It can manifest as primary amenorrhea with onset before menarche or secondary amenorrhea. Evidence: PCS. (PMID:10528856)
- Increased circulating gonadotropin level (HP:0000837): Overproduction of gonadotropins (FSH, LH) by the anterior pituitary gland. Evidence: IEA. (OMIM:311360)
- Irregular menstruation (HP:0000858): Abnormally high variation in the amount of time between periods. Evidence: IEA. (OMIM:311360)
- Adult onset (HP:0003581): Onset of disease manifestations in adulthood, defined here as at the age of 16 years or later. Evidence: PCS. (PMID:10528856)
- X-linked inheritance (HP:0001417): A mode of inheritance that is observed for traits related to a gene encoded on the X chromosome. Evidence: PCS. (PMID:10528856)